- Abnormal metaphysis morphology (HP:0000944): An abnormality of one or more metaphysis, i.e., of the somewhat wider portion of a long bone that is adjacent to the epiphyseal growth plate and grows during childhood. Evidence: TAS. Frequency: Very frequent (HP:0040281). (ORPHA:2780)
- Thickened calvaria (HP:0002684): The presence of an abnormally thick calvaria. Evidence: TAS. Frequency: Very frequent (HP:0040281). (ORPHA:2780)
- Facial hyperostosis (HP:0005465): Excessive growth (overgrowth) of the facial bones, that is of the facial skeleton. Evidence: TAS. Frequency: Very frequent (HP:0040281). (ORPHA:2780)
- High iliac wing (HP:0008808): Increased height of the wing (or ala) of the ilium (which is the large expanded portion which bounds the greater pelvis laterally). Evidence: TAS. Frequency: Very frequent (HP:0040281). (ORPHA:2780)
- Large iliac wing (HP:0008818): Increased size of the ilium ala. Evidence: TAS. Frequency: Very frequent (HP:0040281). (ORPHA:2780)
- Increased bone mineral density (HP:0011001): An abnormal increase of bone mineral density, that is, of the amount of matter per cubic centimeter of bones which is often referred to as osteosclerosis. Osteosclerosis can be detected on radiological examination as an increased whiteness (density) of affected bones. Evidence: TAS. Frequency: Very frequent (HP:0040281). (ORPHA:2780)
- Osteopetrosis (HP:0011002): Abnormally increased formation of dense trabecular bone tissue. Despite the increased density of bone tissue, osteopetrotic bones tend to be more fracture-prone than normal. Evidence: TAS. Frequency: Very frequent (HP:0040281). (ORPHA:2780)
- Coarse metaphyseal trabecularization (HP:0100670): Coarse appearance of the components of the network of osseous tissue that makes up the cancellous structure of a bone, i.e., thickening of the (usually fine) white lines that are produced by trabeculae in radiograms. Evidence: TAS. Frequency: Very frequent (HP:0040281). (ORPHA:2780)
- Cleft palate (HP:0000175): Cleft palate is a developmental defect of the palate resulting from a failure of fusion of the palatine processes and manifesting as a separation of the roof of the mouth (soft and hard palate). Evidence: TAS. Frequency: Frequent (HP:0040282). (ORPHA:2780)
- Submucous cleft hard palate (HP:0000176): Hard-palate submucous clefts are characterized by bony defects in the midline of the bony palate that are covered by the mucous membrane of the roof of the mouth. It may be possible to detect a submucous cleft hard palate upon palpation as a notch in the bony palate. Evidence: TAS. Frequency: Frequent (HP:0040282). (ORPHA:2780)
- Bifid uvula (HP:0000193): Uvula separated into two parts most easily seen at the tip. Evidence: TAS. Frequency: Frequent (HP:0040282). (ORPHA:2780)
- Large fontanelles (HP:0000239): In newborns, the two frontal bones, two parietal bones, and one occipital bone are joined by fibrous sutures, which form a small posterior fontanelle, and a larger, diamond-shaped anterior fontanelle. These regions allow for the skull to pass the birth canal and for later growth. The fontanelles gradually ossify, whereby the posterior fontanelle usually closes by eight weeks and the anterior fontanelle by the 9th to 16th month of age. Large fontanelles are diagnosed if the fontanelles are larger than age-dependent norms. Evidence: TAS. Frequency: Frequent (HP:0040282). (ORPHA:2780)
- Macrocephaly (HP:0000256): Occipitofrontal (head) circumference greater than 97th centile compared to appropriate, age matched, sex-matched normal standards. Alternatively, a apparently increased size of the cranium. Evidence: TAS. Frequency: Frequent (HP:0040282). (ORPHA:2780)
- Delayed cranial suture closure (HP:0000270): Infants normally have two fontanels at birth, the diamond-shaped anterior fontanelle at the junction of the coronal and sagittal sutures, and the posterior fontanelle at the intersection of the occipital and parietal bones. The posterior fontanelle usually closes by the 8th week of life, and the anterior fontanel closes by the 18th month of life on average. This term applies if there is delay of closure of the fontanelles beyond the normal age. Evidence: TAS. Frequency: Frequent (HP:0040282). (ORPHA:2780)
- Conductive hearing impairment (HP:0000405): An abnormality of vibrational conductance of sound to the inner ear leading to impairment of sensory perception of sound. Evidence: TAS. Frequency: Frequent (HP:0040282). (ORPHA:2780)
- Wide nasal bridge (HP:0000431): Increased breadth of the nasal bridge (and with it, the nasal root). Evidence: TAS. Frequency: Frequent (HP:0040282). (ORPHA:2780)
- Delayed eruption of teeth (HP:0000684): Delayed tooth eruption, which can be defined as tooth eruption more than 2 SD beyond the mean eruption age. Evidence: TAS. Frequency: Frequent (HP:0040282). (ORPHA:2780)
- Frontal bossing (HP:0002007): Bilateral bulging of the lateral frontal bone prominences with relative sparing of the midline. Evidence: TAS. Frequency: Frequent (HP:0040282). (ORPHA:2780)
- Scoliosis (HP:0002650): The presence of an abnormal lateral curvature of the spine. Evidence: TAS. Frequency: Frequent (HP:0040282). (ORPHA:2780)
- High, narrow palate (HP:0002705): The presence of a high and narrow palate. Evidence: TAS. Frequency: Frequent (HP:0040282). (ORPHA:2780)
- Flat occiput (HP:0005469): Reduced convexity of the occiput (posterior part of skull). Evidence: TAS. Frequency: Frequent (HP:0040282). (ORPHA:2780)
- Prominent forehead (HP:0011220): Forward prominence of the entire forehead, due to protrusion of the frontal bone. Evidence: TAS. Frequency: Frequent (HP:0040282). (ORPHA:2780)
- Brachycephaly (HP:0000248): An abnormality of skull shape characterized by a decreased anterior-posterior diameter. That is, a cephalic index greater than 81%. Alternatively, an apparently shortened anteroposterior dimension (length) of the head compared to width. Evidence: TAS. Frequency: Occasional (HP:0040283). (ORPHA:2780)
- Retrognathia (HP:0000278): An abnormality in which the mandible is mislocalised posteriorly. Evidence: TAS. Frequency: Occasional (HP:0040283). (ORPHA:2780)
- Epicanthus (HP:0000286): A fold of skin starting above the medial aspect of the upper eyelid and arching downward to cover, pass in front of and lateral to the medial canthus. Evidence: TAS. Frequency: Occasional (HP:0040283). (ORPHA:2780)
- Micrognathia (HP:0000347): Developmental hypoplasia of the mandible. Evidence: TAS. Frequency: Occasional (HP:0040283). (ORPHA:2780)
- Posteriorly rotated ears (HP:0000358): A type of abnormal location of the ears in which the position of the ears is characterized by posterior rotation (the superior part of the ears is rotated towards the back of the head, and the inferior part of the ears towards the front). Evidence: TAS. Frequency: Occasional (HP:0040283). (ORPHA:2780)
- Low-set ears (HP:0000369): Upper insertion of the ear to the scalp below an imaginary horizontal line drawn between the inner canthi of the eye and extending posteriorly to the ear. Evidence: TAS. Frequency: Occasional (HP:0040283). (ORPHA:2780)
- Cataract (HP:0000518): A cataract is an opacity or clouding that develops in the crystalline lens of the eye or in its capsule. Evidence: TAS. Frequency: Occasional (HP:0040283). (ORPHA:2780)
- Intellectual disability (HP:0001249): The term intellectual disability or intellectual developmental disorder is used to describe significantly sub-average intellectual and adaptive functioning based on clinical assessment and as measured by individually administered, appropriately normed, standardized and validated tests of intellectual functioning and adaptive behavior, with onset during the developmental period from infancy through adolescence. Evidence: TAS. Frequency: Occasional (HP:0040283). (ORPHA:2780)
- Global developmental delay (HP:0001263): A delay in the achievement of motor or mental milestones in the domains of development of a child, including motor skills, speech and language, cognitive skills, and social and emotional skills. This term should only be used to describe children younger than five years of age. Evidence: TAS. Frequency: Occasional (HP:0040283). (ORPHA:2780)
- Specific learning disability (HP:0001328): Impairment of certain skills such as reading or writing, coordination, self-control, or attention that interfere with the ability to learn. The impairment is not related to a global deficiency of intelligence. Evidence: TAS. Frequency: Occasional (HP:0040283). (ORPHA:2780)
- Asymmetry of the thorax (HP:0001555): Lack of symmetry between the left and right halves of the thorax. Evidence: TAS. Frequency: Occasional (HP:0040283). (ORPHA:2780)
- Aortic valve stenosis (HP:0001650): The presence of a stenosis (narrowing) of the aortic valve. Evidence: TAS. Frequency: Occasional (HP:0040283). (ORPHA:2780)
- Coarctation of aorta (HP:0001680): Coarctation of the aorta is a narrowing or constriction of a segment of the aorta. Evidence: TAS. Frequency: Occasional (HP:0040283). (ORPHA:2780)
- Mutism (HP:0002300): Complete lack of speech or verbal communication in a person despite attempts to engage in conversation. Mutism as a phenomena assumes the individual has previous capacity for speech and in the pediatric population it assumes that the person is past the age of typical language development. Evidence: TAS. Frequency: Occasional (HP:0040283). (ORPHA:2780)
- Aphasia (HP:0002381): An acquired language impairment of some or all of the abilities to produce or comprehend speech and to read or write. Evidence: TAS. Frequency: Occasional (HP:0040283). (ORPHA:2780)
- Cerebral calcification (HP:0002514): The presence of calcium deposition within the cerebrum. Evidence: TAS. Frequency: Occasional (HP:0040283). (ORPHA:2780)
- Spina bifida occulta (HP:0003298): The closed form of spina bifida with incomplete closure of a vertebral body with intact overlying skin. Evidence: TAS. Frequency: Occasional (HP:0040283). (ORPHA:2780)
- Hyperlordosis (HP:0003307): Abnormally increased curvature (anterior concavity) of the lumbar or cervical spine. Evidence: TAS. Frequency: Occasional (HP:0040283). (ORPHA:2780)
- Severe short stature (HP:0003510): A severe degree of short stature, more than -4 SD from the mean corrected for age and sex. Evidence: TAS. Frequency: Occasional (HP:0040283). (ORPHA:2780)
- Echolalia (HP:0010529): Echolalia is the automatic imitative repetition of sounds, words, or phrases in the absence of explicit awareness. The repeated words or phrases are typically odd or used in a non-social manner. These can be words or phrases that the affected individual has heard or invented. Evidence: TAS. Frequency: Occasional (HP:0040283). (ORPHA:2780)
- Facial palsy (HP:0010628): Facial nerve palsy is a dysfunction of cranial nerve VII (the facial nerve) that results in inability to control facial muscles on the affected side with weakness of the muscles of facial expression and eye closure. This can either be present in unilateral or bilateral form. Evidence: TAS. Frequency: Occasional (HP:0040283). (ORPHA:2780)
- Flat face (HP:0012368): Absence of concavity or convexity of the face when viewed in profile. Evidence: TAS. Frequency: Occasional (HP:0040283). (ORPHA:2780)
These phenotypes are associated with the disease Osteopathia striata-cranial sclerosis syndrome (ORPHA:2780).